- Acute leukemia (HP:0002488): A clonal (malignant) hematopoietic disorder with an acute onset, affecting the bone marrow and the peripheral blood. The malignant cells show minimal differentiation and are called blasts, either myeloid blasts (myeloblasts) or lymphoid blasts (lymphoblasts). Evidence: IEA. (OMIM:308960)
- X-linked inheritance (HP:0001417): A mode of inheritance that is observed for traits related to a gene encoded on the X chromosome. Evidence: TAS. (OMIM:308960)
These phenotypes are associated with the disease leukemia, acute, X-linked (OMIM:308960).